Phenotypes associated with the disease FETAL HEMOGLOBIN QUANTITATIVE TRAIT LOCUS 5 (OMIM:142335):
- Persistence of hemoglobin F (HP:0011904): Hemoglobin F (HbF) contains two globin alpha chains and two globin gamma chains. It is the main form of hemoglobin in the fetus during the last seven months of intrauterine development and in the half year of postnatal life. In adults it normally makes up less than one percent of all hemoglobin. This term refers to an increase in HbF above this limit. In beta thalassemia major, it may represent over 90 percent of all hemoglobin, and in beta thalassemia minor it may make up between 0.5 to 4 percent. Evidence: PCS. (PMID:17767159)
- Autosomal dominant inheritance (HP:0000006): A mode of inheritance that is observed for traits related to a gene encoded on one of the autosomes (i.e., the human chromosomes 1-22) in which a trait manifests in heterozygotes. In the context of medical genetics, an autosomal dominant disorder is caused when a single copy of the mutant allele is present. Males and females are affected equally, and can both transmit the disorder with a risk of 50% for each child of inheriting the mutant allele. Evidence: TAS. (OMIM:142335)